- Erythema (HP:0010783, a Human Phenotype Ontology term): Redness of the skin, caused by hyperemia of the capillaries in the lower layers of the skin. Evidence: IEA. (OMIM:169600)
- Autosomal dominant inheritance (HP:0000006, a Human Phenotype Ontology term): A mode of inheritance that is observed for traits related to a gene encoded on one of the autosomes (i.e., the human chromosomes 1-22) in which a trait manifests in heterozygotes. In the context of medical genetics, an autosomal dominant disorder is caused when a single copy of the mutant allele is present. Males and females are affected equally, and can both transmit the disorder with a risk of 50% for each child of inheriting the mutant allele. Evidence: IEA. (OMIM:169600)
These phenotypes are associated with the disease Hailey-Hailey disease (OMIM:169600, an entry in Online Mendelian Inheritance in Man).